Phenotypes associated with the disease paroxysmal nocturnal hemoglobinuria 2 (OMIM:615399):
- Diarrhea (HP:0002014): Abnormally increased frequency (usually defined as three or more) loose or watery bowel movements a day. Evidence: PCS. Frequency: 1/1. (PMID:23733340)
- Middle age onset (HP:0003596): A type of adult onset with onset of symptoms at the age of 40 to 60 years. Evidence: PCS. Frequency: 1/1. (PMID:23733340)
- Typified by somatic mosaicism (HP:0001442): Description of conditions in which affected individuals typically display somatic mosaicism, i.e., genetically distinct populations of somatic cells in a given organism caused by DNA mutations, epigenetic alterations of DNA, chromosomal abnormalities or the spontaneous reversion of inherited mutations. In many conditions typified by somatic mosaicism, constitutive mutation is lethal and cases are exclusively or predominantly mosaic. Evidence: PCS. (PMID:23733340)
- Arthralgia (HP:0002829): Joint pain. Evidence: PCS. Frequency: 1/1. (PMID:23733340)
- Paroxysmal nocturnal hemoglobinuria (HP:0004818). Evidence: PCS. Frequency: 1/1. (PMID:23733340)
- Hemolytic anemia (HP:0001878): A type of anemia caused by premature destruction of red blood cells (hemolysis). Evidence: PCS. Frequency: 1/1. (PMID:23733340)
- Dyspnea (HP:0002094): Difficult or labored breathing. Dyspnea is a subjective feeling only the patient can rate, e.g., on a Borg scale. Evidence: PCS. Frequency: 1/1. (PMID:23733340)
- Headache (HP:0002315): Cephalgia, or pain sensed in various parts of the head, not confined to the area of distribution of any nerve. Evidence: PCS. Frequency: 1/1. (PMID:23733340)
- Fatigue (HP:0012378): A subjective feeling of tiredness characterized by a lack of energy and motivation. Evidence: PCS. Frequency: 1/1. (PMID:23733340)
- Abdominal pain (HP:0002027): An unpleasant sensation characterized by physical discomfort (such as pricking, throbbing, or aching) and perceived to originate in the abdomen. Evidence: PCS. Frequency: 1/1. (PMID:23733340)
- Autosomal dominant inheritance (HP:0000006): A mode of inheritance that is observed for traits related to a gene encoded on one of the autosomes (i.e., the human chromosomes 1-22) in which a trait manifests in heterozygotes. In the context of medical genetics, an autosomal dominant disorder is caused when a single copy of the mutant allele is present. Males and females are affected equally, and can both transmit the disorder with a risk of 50% for each child of inheriting the mutant allele. Evidence: PCS. (PMID:23733340)